Phenotypes associated with the disease Branchio-oculo-facial syndrome (ORPHA:1297):
- Posteriorly rotated ears (HP:0000358): A type of abnormal location of the ears in which the position of the ears is characterized by posterior rotation (the superior part of the ears is rotated towards the back of the head, and the inferior part of the ears towards the front). Evidence: TAS. Frequency: Very frequent (HP:0040281). (ORPHA:1297)
- Everted lower lip vermilion (HP:0000232): An abnormal configuration of the lower lip such that it is turned outward i.e., everted, with the Inner aspect of the lower lip vermilion (normally opposing the teeth) being visible in a frontal view. Evidence: TAS. Frequency: Very frequent (HP:0040281). (ORPHA:1297)
- Abnormal pinna morphology (HP:0000377): An abnormality of the pinna, which is also referred to as the auricle or external ear. Evidence: TAS. Frequency: Very frequent (HP:0040281). (ORPHA:1297)
- Conductive hearing impairment (HP:0000405): An abnormality of vibrational conductance of sound to the inner ear leading to impairment of sensory perception of sound. Evidence: TAS. Frequency: Very frequent (HP:0040281). (ORPHA:1297)
- Coloboma (HP:0000589): A developmental defect characterized by a cleft of some portion of the eye or ocular adnexa. Evidence: TAS. Frequency: Very frequent (HP:0040281). (ORPHA:1297)
- Atypical scarring of skin (HP:0000987): Atypically scarred skin . Evidence: TAS. Frequency: Very frequent (HP:0040281). (ORPHA:1297)
- Hemangioma (HP:0001028): A hemangioma is a benign tumor characterized by blood-filled spaces lined by benign endothelial cells. A hemangioma characterized by large endothelial spaces (caverns) is called a cavernous hemangioma (in contrast to a hemangioma with small endothelial spaces, which is called capillary hemangioma). Evidence: TAS. Frequency: Very frequent (HP:0040281). (ORPHA:1297)
- Deep philtrum (HP:0002002): Accentuated, prominent philtral ridges giving rise to an exaggerated groove in the midline between the nasal base and upper vermillion border. Evidence: TAS. Frequency: Very frequent (HP:0040281). (ORPHA:1297)
- Postauricular pit (HP:0004464): Benign congenital lesion of the postauricular soft tissue consisting of a blind-ending narrow tube or pit. Evidence: TAS. Frequency: Very frequent (HP:0040281). (ORPHA:1297)
- Preauricular pit (HP:0004467): Small indentation anterior to the insertion of the ear. Evidence: TAS. Frequency: Very frequent (HP:0040281). (ORPHA:1297)
- Supraauricular pit (HP:0008606): Benign congenital lesion of the supraauricular soft tissue consisting of a blind-ending narrow tube or pit. Evidence: TAS. Frequency: Very frequent (HP:0040281). (ORPHA:1297)
- High palate (HP:0000218): Height of the palate more than 2 SD above the mean (objective) or palatal height at the level of the first permanent molar more than twice the height of the teeth (subjective). Evidence: TAS. Frequency: Frequent (HP:0040282). (ORPHA:1297)
- Dolichocephaly (HP:0000268): An abnormality of skull shape characterized by a increased anterior-posterior diameter, i.e., an increased antero-posterior dimension of the skull. Cephalic index less than 76%. Alternatively, an apparently increased antero-posterior length of the head compared to width. Often due to premature closure of the sagittal suture. Evidence: TAS. Frequency: Frequent (HP:0040282). (ORPHA:1297)
- Wide nasal bridge (HP:0000431): Increased breadth of the nasal bridge (and with it, the nasal root). Evidence: TAS. Frequency: Frequent (HP:0040282). (ORPHA:1297)
- Broad nasal tip (HP:0000455): Increase in width of the nasal tip. Evidence: TAS. Frequency: Frequent (HP:0040282). (ORPHA:1297)
- Nasolacrimal duct obstruction (HP:0000579): Blockage of the lacrimal duct. Evidence: TAS. Frequency: Frequent (HP:0040282). (ORPHA:1297)
- Upslanted palpebral fissure (HP:0000582): The palpebral fissure inclination is more than two standard deviations above the mean for age (objective); or, the inclination of the palpebral fissure is greater than typical for age. Evidence: TAS. Frequency: Frequent (HP:0040282). (ORPHA:1297)
- Iris coloboma (HP:0000612): A coloboma of the iris. Evidence: TAS. Frequency: Frequent (HP:0040282). (ORPHA:1297)
- Microdontia (HP:0000691): Decreased size of the teeth, which can be defined as a mesiodistal tooth diameter (width) more than 2 SD below mean. Alternatively, an apparently decreased maximum width of tooth. Evidence: TAS. Frequency: Frequent (HP:0040282). (ORPHA:1297)
- Intrauterine growth retardation (HP:0001511): An abnormal restriction of fetal growth with fetal weight below the tenth percentile for gestational age. Evidence: TAS. Frequency: Frequent (HP:0040282). (ORPHA:1297)
- Hypernasal speech (HP:0001611): A type of speech characterized by the presence of an abnormally increased nasal airflow during speech associated with structural abnormality of the nasal passages. Evidence: TAS. Frequency: Frequent (HP:0040282). (ORPHA:1297)
- Abnormal speech pattern (HP:0002167): An abnormality in the sound (volume) or cadence (rate) of speech. Evidence: TAS. Frequency: Frequent (HP:0040282). (ORPHA:1297)
- Premature graying of hair (HP:0002216): Development of gray hair at a younger than normal age. Evidence: TAS. Frequency: Frequent (HP:0040282). (ORPHA:1297)
- Short stature (HP:0004322): A height below that which is expected according to age and gender norms. Although there is no universally accepted definition of short stature, many refer to "short stature" as height more than 2 standard deviations below the mean for age and gender (or below the 3rd percentile for age and gender dependent norms). Evidence: TAS. Frequency: Frequent (HP:0040282). (ORPHA:1297)
- Tooth agenesis (HP:0009804): The absence of one or more teeth from the normal series by a failure to develop. Evidence: TAS. Frequency: Frequent (HP:0040282). (ORPHA:1297)
- Non-midline cleft of the upper lip (HP:0100335): Clefting (gap or groove) of the upper lip affecting the lateral portions of the upper lip rather than the midline/median region. Evidence: TAS. Frequency: Frequent (HP:0040282). (ORPHA:1297)
- Fingernail dysplasia (HP:0100798): An abnormality of the development of the fingernails. Evidence: TAS. Frequency: Frequent (HP:0040282). (ORPHA:1297)
- Multicystic kidney dysplasia (HP:0000003): Multicystic dysplasia of the kidney is characterized by multiple cysts of varying size in the kidney and the absence of a normal pelvicaliceal system. The condition is associated with ureteral or ureteropelvic atresia, and the affected kidney is nonfunctional. Evidence: TAS. Frequency: Occasional (HP:0040283). (ORPHA:1297)
- Renal agenesis (HP:0000104): Agenesis, that is, failure of the kidney to develop during embryogenesis and development. Evidence: TAS. Frequency: Occasional (HP:0040283). (ORPHA:1297)
- Hydronephrosis (HP:0000126): Severe distention of the kidney with dilation of the renal pelvis and calices. Evidence: TAS. Frequency: Occasional (HP:0040283). (ORPHA:1297)
- Orofacial cleft (HP:0000202): The presence of a cleft (gap, opening, or groove) in the oral cavity, including cleft of the upper lip and/or cleft of the palate. Cleft of the upper lip is visible as a groove or fissure in the lip, most frequently due to a congenital failure of the maxillary and median nasal processes to fuse. Cleft palate is characterized by a grooved depression or fissure in the roof of the mouth, most often resulting from a congenital failure of the palate to fuse properly. Clefts of the lip and palate can occur individually or together. It is preferable to code each defect separately. Evidence: TAS. Frequency: Occasional (HP:0040283). (ORPHA:1297)
- Microcornea (HP:0000482): A congenital abnormality of the cornea in which the cornea and the anterior segment of the eye are smaller than normal. The horizontal diameter of the cornea does not reach 10 mm even in adulthood. Evidence: TAS. Frequency: Occasional (HP:0040283). (ORPHA:1297)
- Strabismus (HP:0000486): A misalignment of the eyes so that the visual axes deviate from bifoveal fixation. The classification of strabismus may be based on a number of features including the relative position of the eyes, whether the deviation is latent or manifest, intermittent or constant, concomitant or otherwise and according to the age of onset and the relevance of any associated refractive error. Evidence: TAS. Frequency: Occasional (HP:0040283). (ORPHA:1297)
- Ptosis (HP:0000508): The upper eyelid margin is positioned 3 mm or more lower than usual and covers the superior portion of the iris (objective); or, the upper lid margin obscures at least part of the pupil (subjective). Evidence: TAS. Frequency: Occasional (HP:0040283). (ORPHA:1297)
- Cataract (HP:0000518): A cataract is an opacity or clouding that develops in the crystalline lens of the eye or in its capsule. Evidence: TAS. Frequency: Occasional (HP:0040283). (ORPHA:1297)
- Preaxial hand polydactyly (HP:0001177): Supernumerary digits located at the radial side of the hand. Polydactyly (supernumerary digits) involving the thumb occurs in many distinct forms of high variability and severity. Ranging from fleshy nubbins over varying degrees of partial duplication/splitting to completely duplicated or even triplicated thumbs or preaxial (on the radial side of the hand) supernumerary digits. Evidence: TAS. Frequency: Occasional (HP:0040283). (ORPHA:1297)
- Upper lip pit (HP:0100268): Depression located on the vermilion of the upper lip, usually paramedian. Evidence: TAS. Frequency: Occasional (HP:0040283). (ORPHA:1297)